- Migraine with aura (HP:0002077): A type of migraine in which there is an aura characterized by focal neurological phenomena that usually proceed, but may accompany or occur in the absence of, the headache. The symptoms of an aura may include fully reversible visual, sensory, and speech symptoms but not motor weakness. Visual symptoms may include flickering lights, spots and lines and/or loss of vision and/or unilateral sensory symptoms such as paresthesias or numbness. At least one of the symptoms of an aura develops gradually over 5 or more minutes and/or different symptoms occur in succession. Evidence: PCS. (PMID:20871611)
- Migraine without aura (HP:0002083): Repeated headache attacks lasting 4-72 h fulfilling at least two of the following criteria: 1) unilateral location, 2) pulsating quality, 3) moderate or severe pain intensity, and 4) aggravation by or causing avoidance of routine physical activity such as climbing stairs. Headache attacks are commonly accompanied by nausea, vomiting, photophobia, or phonophobia. Evidence: PCS. (PMID:20871611)
- Autosomal dominant inheritance (HP:0000006): A mode of inheritance that is observed for traits related to a gene encoded on one of the autosomes (i.e., the human chromosomes 1-22) in which a trait manifests in heterozygotes. In the context of medical genetics, an autosomal dominant disorder is caused when a single copy of the mutant allele is present. Males and females are affected equally, and can both transmit the disorder with a risk of 50% for each child of inheriting the mutant allele. Evidence: PCS. (PMID:20871611)
These phenotypes are associated with the disease migraine, with or without aura, susceptibility to, 13 (OMIM:613656).